Phenotypes associated with the disease atrial septal defect 3 (OMIM:614089):
- Secundum atrial septal defect (HP:0001684): A kind of atrial septum defect arising from an enlarged foramen ovale, inadequate growth of the septum secundum, or excessive absorption of the septum primum. Evidence: PCS. (PMID:15735645)
- Autosomal dominant inheritance (HP:0000006): A mode of inheritance that is observed for traits related to a gene encoded on one of the autosomes (i.e., the human chromosomes 1-22) in which a trait manifests in heterozygotes. In the context of medical genetics, an autosomal dominant disorder is caused when a single copy of the mutant allele is present. Males and females are affected equally, and can both transmit the disorder with a risk of 50% for each child of inheriting the mutant allele. Evidence: PCS. (PMID:15735645)